- Long face (HP:0000276): Facial height (length) is more than 2 standard deviations above the mean (objective); or, an apparent increase in the height (length) of the face (subjective). Evidence: IEA. (DECIPHER:57)
- Small for gestational age (HP:0001518): Smaller than normal size according to sex and gestational age related norms, defined as a weight below the 10th percentile for the gestational age. Evidence: IEA. (DECIPHER:57)
- Hypotonia (HP:0001252): Hypotonia is an abnormally low muscle tone (the amount of tension or resistance to movement in a muscle). Even when relaxed, muscles have a continuous and passive partial contraction which provides some resistance to passive stretching. Hypotonia thus manifests as diminished resistance to passive stretching. Hypotonia is not the same as muscle weakness, although the two conditions can co-exist. Evidence: IEA. (DECIPHER:57)
- Feeding difficulties in infancy (HP:0008872): Impaired feeding performance of an infant as manifested by difficulties such as weak and ineffective sucking, brief bursts of sucking, and falling asleep during sucking. There may be difficulties with chewing or maintaining attention. Evidence: IEA. (DECIPHER:57)
- Intellectual disability (HP:0001249): The term intellectual disability or intellectual developmental disorder is used to describe significantly sub-average intellectual and adaptive functioning based on clinical assessment and as measured by individually administered, appropriately normed, standardized and validated tests of intellectual functioning and adaptive behavior, with onset during the developmental period from infancy through adolescence. Evidence: IEA. (DECIPHER:57)
These phenotypes are associated with the disease Koolen-de Vries syndrome due to 17q21.31 microdeletion syndrome (DECIPHER:57).